- Congenital onset (HP:0003577): A phenotypic abnormality that is present at birth. Evidence: PCS. Frequency: 2/2. (PMID:22577226)
- Situs inversus totalis (HP:0001696): A left-right reversal (or mirror reflection) of the anatomical location of the major thoracic and abdominal organs. Evidence: PCS. Frequency: 1/2. (PMID:22577226)
- Dextrocardia (HP:0001651): The heart is located in the right hand sided hemithorax. That is, there is a left-right reversal (or "mirror reflection") of the anatomical location of the heart in which the heart is locate on the right side instead of the left. Evidence: PCS. Frequency: 1/2. (PMID:22577226)
- Abdominal situs inversus (HP:0003363): A left-right reversal (or mirror reflection) of the anatomical location of the viscera of the abdomen. Evidence: TAS. (OMIM:614779)
- Double outlet right ventricle (HP:0001719): Double outlet right ventricle (DORV) is a type of ventriculoarterial connection in which both great vessels arise entirely or predominantly from the right ventricle. Evidence: PCS. Frequency: 1/2. (PMID:22577226)
- Right aortic arch (HP:0012020): Aorta descends on right instead of on the left. Evidence: PCS. Frequency: 1/2. (PMID:22577226)
- Transposition of the great arteries (HP:0001669): A complex congenital heart defect in which the aorta arises from the morphologic right ventricle and the pulmonary artery arises from the morphologic left ventricle. Evidence: PCS. Frequency: 1/2. (PMID:22577226)
- Hypoplastic left ventricle (HP:0004383): A severe congenital heart defect characterized by underdevelopment of the left ventricle. Evidence: PCS. Frequency: 1/2. (PMID:22577226)
- Autosomal recessive inheritance (HP:0000007): A mode of inheritance that is observed for traits related to a gene encoded on one of the autosomes (i.e., the human chromosomes 1-22) in which a trait manifests in individuals with two pathogenic alleles, either homozygotes (two copies of the same mutant allele) or compound heterozygotes (whereby each copy of a gene has a distinct mutant allele). Evidence: PCS. (PMID:22577226)
- Common atrium (HP:0011565): Complete absence of the interatrial septum with common atrioventricular valve and two atrioventricular connections. Evidence: PCS. Frequency: 1/2. (PMID:22577226)
- Total anomalous pulmonary venous return (HP:0005160): Total anomalous pulmonary venous return refers to a congenital malformation in which all four pulmonary veins do not connect normally to the left atrium, but instead drain abnormally to the right atrium. Evidence: PCS. Frequency: 1/2. (PMID:22577226)
- Unbalanced atrioventricular canal defect (HP:0011579): Anatomic features of unbalanced atrioventricular septal defect (AVSD) include varying amounts of ventricular hypoplasia, as well as malalignment of the atrioventricular junction. In complete AVSD, the common AV valve can be situated either equally over the right and left ventricles (balanced) or unequally over the ventricles (unbalanced). Evidence: PCS. Frequency: 1/2. (PMID:22577226)
These phenotypes are associated with the disease heterotaxy, visceral, 6, autosomal (OMIM:614779).